- Eosinophil nuclear hypersegmentation (HP:0034253): An excessive division of the lobes of the nucleus of eosinophils. Eosinophils with more than two nuclear lobes are commonly regarded as hypersegmented, because seventy to ninety percent of peripheral blood eosinophils have two nuclear lobes. Evidence: PCS. Frequency: 1/1. (PMID:7809065)
- Autosomal recessive inheritance (HP:0000007): A mode of inheritance that is observed for traits related to a gene encoded on one of the autosomes (i.e., the human chromosomes 1-22) in which a trait manifests in individuals with two pathogenic alleles, either homozygotes (two copies of the same mutant allele) or compound heterozygotes (whereby each copy of a gene has a distinct mutant allele). Evidence: PCS. (PMID:7809065)
These phenotypes are associated with the disease eosinophil peroxidase deficiency (OMIM:261500).